Phenotypes associated with the disease pontocerebellar hypoplasia type 2E (OMIM:615851):
- Epicanthus (HP:0000286): A fold of skin starting above the medial aspect of the upper eyelid and arching downward to cover, pass in front of and lateral to the medial canthus. Evidence: PCS. Frequency: 2/2. (PMID:30100179)
- Hypertonia (HP:0001276): A condition in which there is increased muscle tone so that arms or legs, for example, are stiff and difficult to move. Evidence: PCS. Frequency: 2/2. (PMID:30100179)
- Narrow forehead (HP:0000341): Width of the forehead or distance between the frontotemporales is more than two standard deviations below the mean (objective); or apparently narrow intertemporal region (subjective). Evidence: PCS. Frequency: 2/2. (PMID:30100179)
- Progressive (HP:0003676): Applies to a disease manifestation that increases in scope or severity over the course of time, i.e., that worsens with age. Evidence: PCS. (PMID:24577744)
- Strabismus (HP:0000486): A misalignment of the eyes so that the visual axes deviate from bifoveal fixation. The classification of strabismus may be based on a number of features including the relative position of the eyes, whether the deviation is latent or manifest, intermittent or constant, concomitant or otherwise and according to the age of onset and the relevance of any associated refractive error. Evidence: PCS. Frequency: 2/2. (PMID:30100179)
- Short stature (HP:0004322): A height below that which is expected according to age and gender norms. Although there is no universally accepted definition of short stature, many refer to "short stature" as height more than 2 standard deviations below the mean for age and gender (or below the 3rd percentile for age and gender dependent norms). Evidence: PCS. (PMID:24577744)
- Cerebellar atrophy (HP:0001272): Cerebellar atrophy is defined as a cerebellum with initially normal structures, in a posterior fossa with normal size, which displays enlarged fissures (interfolial spaces) in comparison to the foliae secondary to loss of tissue. Cerebellar atrophy implies irreversible loss of tissue and result from an ongoing progressive disease until a final stage is reached or a single injury, e.g. an intoxication or infectious event. Evidence: PCS. Frequency: 12/12. (PMID:30100179;PMID:24577744)
- Flexion contracture (HP:0001371): A flexion contracture is a bent (flexed) joint that cannot be straightened actively or passively. It is thus a chronic loss of joint motion due to structural changes in muscle, tendons, ligaments, or skin that prevents normal movement of joints. Evidence: PCS. Onset: Juvenile onset (HP:0003621). (PMID:24577744)
- Profound intellectual disability (HP:0002187): Profound intellectual disability (ID) is defined as a type of ID characterized by profoundly sub-average adaptive functioning and intellectual functioning, with an intelligence quotient (IQ) below 20. Evidence: TAS. (OMIM:615851)
- Short nose (HP:0003196): Distance from nasion to subnasale more than two standard deviations below the mean, or alternatively, an apparently decreased length from the nasal root to the nasal tip. Evidence: PCS. Frequency: 2/2. (PMID:30100179)
- Infantile onset (HP:0003593): Onset of signs or symptoms of disease between 28 days to one year of life. Evidence: PCS. Frequency: 12/12. (PMID:30100179;PMID:24577744)
- Myoclonic seizure (HP:0032794): A myoclonic seizure is a type of motor seizure characterized by sudden, brief (<100 ms) involuntary single or multiple contraction of muscles or muscle groups of variable topography (axial, proximal limb, distal). Myoclonus is less regularly repetitive and less sustained than is clonus. Evidence: PCS. (PMID:24577744)
- Infantile spasms (HP:0012469): Infantile spasms represent a subset of "epileptic spasms". Infantile Spasms are epileptic spasms starting in the first year of life (infancy). Evidence: PCS. Frequency: 2/2. Onset: Infantile onset (HP:0003593). (PMID:30100179)
- Facial telangiectasia (HP:0007380): Telangiectases (small dilated blood vessels) located near the surface of the skin of the face. Evidence: PCS. Frequency: 2/2. (PMID:30100179)
- Osteoporosis (HP:0000939): Osteoporosis is a systemic skeletal disease characterized by low bone density and microarchitectural deterioration of bone tissue with a consequent increase in bone fragility. According to the WHO criteria, osteoporosis is defined as a BMD that lies 2.5 standard deviations or more below the average value for young healthy adults (a T-score below -2.5 SD). Evidence: PCS. (PMID:24577744)
- Failure to thrive (HP:0001508): Failure to thrive (FTT) refers to a child whose physical growth is substantially below the norm. Evidence: PCS. Frequency: 1/2. (PMID:30100179)
- Irritability (HP:0000737): An emotional state characterized by negative feelings of heightened frustration, annoyance, or feeling upset, often triggered by internal factors (e.g., fatigue, hunger, unfulfilled desires) or external factors (e.g., social or environmental challenges). Irritability may be unpredictable, and is accompanied by a lowered threshold for emotional reactivity and observable features (speech, facial expressions, or psychomotor activity). Evidence: PCS. (PMID:24577744)
- Ventriculomegaly (HP:0002119): An increase in size of the ventricular system of the brain. Evidence: PCS. Frequency: 1/2. (PMID:30100179)
- Intellectual disability (HP:0001249): The term intellectual disability or intellectual developmental disorder is used to describe significantly sub-average intellectual and adaptive functioning based on clinical assessment and as measured by individually administered, appropriately normed, standardized and validated tests of intellectual functioning and adaptive behavior, with onset during the developmental period from infancy through adolescence. Evidence: PCS. Frequency: 10/10. (PMID:24577744)
- Large earlobe (HP:0009748): Increased volume of the earlobe, that is, abnormally prominent ear lobules. Evidence: PCS. Frequency: 2/2. (PMID:30100179)
- Opisthotonus (HP:0002179): Opisthotonus is defined as a dramatic abnormal posture due to spastic contraction of the extensor muscles of the neck, trunk, and lower extremities that produces a severe backward arching from neck to heel. In most cases, the trunk is elevated off the ground by a few inches. It is usually sudden in onset and can be sustained or repetitive. It can be considered a variant of decerebrate posturing involving a hyperextension of the neck, back, and limbs. Evidence: PCS. Frequency: 10/10. (PMID:24577744)
- Progressive microcephaly (HP:0000253): Progressive microcephaly is diagnosed when the head circumference falls progressively behind age- and gender-dependent norms. Evidence: PCS. (PMID:24577744)
- Cerebral atrophy (HP:0002059): Atrophy (wasting, decrease in size of cells or tissue) affecting the cerebrum. Evidence: PCS. Frequency: 12/12. (PMID:30100179;PMID:24577744)
- Microcephaly (HP:0000252): Head circumference below 2 standard deviations below the mean for age and gender. Evidence: PCS. (PMID:24577744)
- Spastic tetraplegia (HP:0002510): Spastic paralysis affecting all four limbs. Evidence: PCS. Frequency: 10/10. (PMID:24577744)
- Scoliosis (HP:0002650): The presence of an abnormal lateral curvature of the spine. Evidence: PCS. Onset: Juvenile onset (HP:0003621). (PMID:24577744)
- Hypoplasia of the corpus callosum (HP:0002079): Underdevelopment of the corpus callosum. Evidence: PCS. (PMID:24577744)
- Global developmental delay (HP:0001263): A delay in the achievement of motor or mental milestones in the domains of development of a child, including motor skills, speech and language, cognitive skills, and social and emotional skills. This term should only be used to describe children younger than five years of age. Evidence: PCS. Frequency: 12/12. (PMID:30100179;PMID:24577744)
- Secondary microcephaly (HP:0005484): Head circumference which falls below 2 standard deviations below the mean for age and gender because of insufficient head growth after birth. Evidence: PCS. Frequency: 2/2. (PMID:30100179)
- Bilateral tonic-clonic seizure with generalized onset (HP:0025190): A bilateral tonic-clonic seizure with generalized onset is a type of bilateral tonic-clonic seizure characterized by generalized onset; these seizures rapidly engage networks in both hemispheres at the start of the seizure. Evidence: PCS. Frequency: 10/10. Onset: Childhood onset (HP:0011463). (PMID:24577744)
- Severe global developmental delay (HP:0011344): A severe delay in the achievement of motor or mental milestones in the domains of development of a child. Evidence: PCS. Frequency: 2/2. (PMID:30100179)
- Tonic seizure (HP:0032792): A tonic seizure is a type of motor seizure characterized by unilateral or bilateral limb stiffening or elevation, often with neck stiffening. Evidence: PCS. Frequency: 2/2. (PMID:30100179)
- Autosomal recessive inheritance (HP:0000007): A mode of inheritance that is observed for traits related to a gene encoded on one of the autosomes (i.e., the human chromosomes 1-22) in which a trait manifests in individuals with two pathogenic alleles, either homozygotes (two copies of the same mutant allele) or compound heterozygotes (whereby each copy of a gene has a distinct mutant allele). Evidence: PCS. (PMID:24577744)
- Neonatal hypotonia (HP:0001319): Muscular hypotonia (abnormally low muscle tone) manifesting in the neonatal period. Evidence: TAS. (OMIM:615851)
- Optic atrophy (HP:0000648): Atrophy of the optic nerve. Optic atrophy results from the death of the retinal ganglion cell axons that comprise the optic nerve and manifesting as a pale optic nerve on fundoscopy. Evidence: PCS. Frequency: 1/2. (PMID:30100179)
- Spasticity (HP:0001257): A motor disorder characterized by a velocity-dependent increase in tonic stretch reflexes with increased muscle tone, exaggerated (hyperexcitable) tendon reflexes. Evidence: PCS. Frequency: 2/2. (PMID:30100179)
- Micrognathia (HP:0000347): Developmental hypoplasia of the mandible. Evidence: PCS. Frequency: 2/2. (PMID:30100179)
- Myoclonus (HP:0001336): Very brief, involuntary random muscular contractions occurring at rest, in response to sensory stimuli, or accompanying voluntary movements. Evidence: PCS. Frequency: 1/2. Onset: Infantile onset (HP:0003593). (PMID:30100179)
- Wide nose (HP:0000445): Interalar distance more than two standard deviations above the mean for age, i.e., an apparently increased width of the nasal base and alae. Evidence: PCS. Frequency: 2/2. (PMID:30100179)